- Schizophrenia (HP:0100753): A mental disorder characterized by a disintegration of thought processes and emotional responsiveness. It most commonly manifests as auditory hallucinations, paranoid or bizarre delusions, or disorganized speech and thinking. It is accompanied by significant social or occupational dysfunction. The onset of symptoms typically occurs in young adulthood, with a global lifetime prevalence of about 1%. This term is not a helpful parent term to describe abnormal experiences. Evidence: PCS. Frequency: 4/4. (PMID:12217952)
- Hyperprolinemia (HP:0008358): The concentration of proline in the blood circulation is above the upper limit of normal. Evidence: PCS. Frequency: 4/4. (PMID:12217952)
- Autosomal dominant inheritance (HP:0000006): A mode of inheritance that is observed for traits related to a gene encoded on one of the autosomes (i.e., the human chromosomes 1-22) in which a trait manifests in heterozygotes. In the context of medical genetics, an autosomal dominant disorder is caused when a single copy of the mutant allele is present. Males and females are affected equally, and can both transmit the disorder with a risk of 50% for each child of inheriting the mutant allele. Evidence: PCS. (PMID:12217952)
These phenotypes are associated with the disease schizophrenia 4 (OMIM:600850).